- Sensorineural hearing impairment (HP:0000407): A type of hearing impairment in one or both ears related to an abnormal functionality of the cochlear nerve. Evidence: IEA. (OMIM:400047)
- Y-linked inheritance (HP:0001450): A mode of inheritance that is observed for traits related to a gene encoded on the Y chromosome. Evidence: TAS. (PMID:30341416)
These phenotypes are associated with the disease deafness, Y-linked 2 (OMIM:400047).